Phenotypes associated with the disease Myxoid/round cell liposarcoma (ORPHA:99967):
- Subcutaneous nodule (HP:0001482): Slightly elevated lesions on or in the skin with a diameter of over 5 mm. Evidence: TAS. Frequency: Very frequent (HP:0040281). (ORPHA:99967)
- Abdominal pain (HP:0002027): An unpleasant sensation characterized by physical discomfort (such as pricking, throbbing, or aching) and perceived to originate in the abdomen. Evidence: TAS. Frequency: Occasional (HP:0040283). (ORPHA:99967)
- Gastrointestinal dysmotility (HP:0002579): Abnormal intestinal contractions, such as spasms and intestinal paralysis, related to the loss of the ability of the gut to coordinate muscular activity because of endogenous or exogenous causes. Evidence: TAS. Frequency: Occasional (HP:0040283). (ORPHA:99967)